Phenotypes associated with the disease Aymé-Gripp syndrome (ORPHA:1272):
- Intellectual disability (HP:0001249): The term intellectual disability or intellectual developmental disorder is used to describe significantly sub-average intellectual and adaptive functioning based on clinical assessment and as measured by individually administered, appropriately normed, standardized and validated tests of intellectual functioning and adaptive behavior, with onset during the developmental period from infancy through adolescence. Evidence: TAS. Frequency: Very frequent (HP:0040281). (ORPHA:1272)
- Global developmental delay (HP:0001263): A delay in the achievement of motor or mental milestones in the domains of development of a child, including motor skills, speech and language, cognitive skills, and social and emotional skills. This term should only be used to describe children younger than five years of age. Evidence: TAS. Frequency: Very frequent (HP:0040281). (ORPHA:1272)
- Postnatal growth retardation (HP:0008897): Slow or limited growth after birth. Evidence: TAS. Frequency: Very frequent (HP:0040281). (ORPHA:1272)
- Flat face (HP:0012368): Absence of concavity or convexity of the face when viewed in profile. Evidence: TAS. Frequency: Very frequent (HP:0040281). (ORPHA:1272)
- Cryptorchidism (HP:0000028): Testis in inguinal canal. That is, absence of one or both testes from the scrotum owing to failure of the testis or testes to descend through the inguinal canal to the scrotum. Evidence: TAS. Frequency: Frequent (HP:0040282). (ORPHA:1272)
- Narrow mouth (HP:0000160): Distance between the commissures of the mouth more than 2 SD below the mean. Alternatively, an apparently decreased width of the oral aperture (subjective). Evidence: TAS. Frequency: Frequent (HP:0040282). (ORPHA:1272)
- Cleft palate (HP:0000175): Cleft palate is a developmental defect of the palate resulting from a failure of fusion of the palatine processes and manifesting as a separation of the roof of the mouth (soft and hard palate). Evidence: TAS. Frequency: Frequent (HP:0040282). (ORPHA:1272)
- Thin upper lip vermilion (HP:0000219): Height of the vermilion of the upper lip in the midline more than 2 SD below the mean. Alternatively, an apparently reduced height of the vermilion of the upper lip in the frontal view (subjective). Evidence: TAS. Frequency: Frequent (HP:0040282). (ORPHA:1272)
- Hydrocephalus (HP:0000238): Hydrocephalus is an active distension of the ventricular system of the brain resulting from inadequate passage of CSF from its point of production within the cerebral ventricles to its point of absorption into the systemic circulation. Evidence: TAS. Frequency: Frequent (HP:0040282). (ORPHA:1272)
- Large fontanelles (HP:0000239): In newborns, the two frontal bones, two parietal bones, and one occipital bone are joined by fibrous sutures, which form a small posterior fontanelle, and a larger, diamond-shaped anterior fontanelle. These regions allow for the skull to pass the birth canal and for later growth. The fontanelles gradually ossify, whereby the posterior fontanelle usually closes by eight weeks and the anterior fontanelle by the 9th to 16th month of age. Large fontanelles are diagnosed if the fontanelles are larger than age-dependent norms. Evidence: TAS. Frequency: Frequent (HP:0040282). (ORPHA:1272)
- Brachycephaly (HP:0000248): An abnormality of skull shape characterized by a decreased anterior-posterior diameter. That is, a cephalic index greater than 81%. Alternatively, an apparently shortened anteroposterior dimension (length) of the head compared to width. Evidence: TAS. Frequency: Frequent (HP:0040282). (ORPHA:1272)
- Hypertelorism (HP:0000316): Interpupillary distance more than 2 SD above the mean (alternatively, the appearance of an increased interpupillary distance or widely spaced eyes). Evidence: TAS. Frequency: Frequent (HP:0040282). (ORPHA:1272)
- Long philtrum (HP:0000343): Distance between nasal base and midline upper lip vermilion border more than 2 SD above the mean. Alternatively, an apparently increased distance between nasal base and midline upper lip vermilion border. Evidence: TAS. Frequency: Frequent (HP:0040282). (ORPHA:1272)
- High forehead (HP:0000348): An abnormally increased height of the forehead. Evidence: TAS. Frequency: Frequent (HP:0040282). (ORPHA:1272)
- Posteriorly rotated ears (HP:0000358): A type of abnormal location of the ears in which the position of the ears is characterized by posterior rotation (the superior part of the ears is rotated towards the back of the head, and the inferior part of the ears towards the front). Evidence: TAS. Frequency: Frequent (HP:0040282). (ORPHA:1272)
- Low-set ears (HP:0000369): Upper insertion of the ear to the scalp below an imaginary horizontal line drawn between the inner canthi of the eye and extending posteriorly to the ear. Evidence: TAS. Frequency: Frequent (HP:0040282). (ORPHA:1272)
- Sensorineural hearing impairment (HP:0000407): A type of hearing impairment in one or both ears related to an abnormal functionality of the cochlear nerve. Evidence: TAS. Frequency: Frequent (HP:0040282). (ORPHA:1272)
- Downslanted palpebral fissures (HP:0000494): The palpebral fissure inclination is more than two standard deviations below the mean. Evidence: TAS. Frequency: Frequent (HP:0040282). (ORPHA:1272)
- Visual impairment (HP:0000505): Visual impairment (or vision impairment) is vision loss (of a person) to such a degree as to qualify as an additional support need through a significant limitation of visual capability resulting from either disease, trauma, or congenital or degenerative conditions that cannot be corrected by conventional means, such as refractive correction, medication, or surgery. Evidence: TAS. Frequency: Frequent (HP:0040282). (ORPHA:1272)
- Cataract (HP:0000518): A cataract is an opacity or clouding that develops in the crystalline lens of the eye or in its capsule. Evidence: TAS. Frequency: Frequent (HP:0040282). (ORPHA:1272)
- Developmental cataract (HP:0000519): A cataract that occurs congenitally as the result of a developmental defect, in contrast to the majority of cataracts that occur in adulthood as the result of degenerative changes of the lens. Evidence: TAS. Frequency: Frequent (HP:0040282). (ORPHA:1272)
- Upslanted palpebral fissure (HP:0000582): The palpebral fissure inclination is more than two standard deviations above the mean for age (objective); or, the inclination of the palpebral fissure is greater than typical for age. Evidence: TAS. Frequency: Frequent (HP:0040282). (ORPHA:1272)
- Shallow orbits (HP:0000586): Reduced depth of the orbits associated with prominent-appearing ocular globes. Evidence: TAS. Frequency: Frequent (HP:0040282). (ORPHA:1272)
- Oligodontia (HP:0000677): The absence of six or more teeth from the normal series by a failure to develop. Evidence: TAS. Frequency: Frequent (HP:0040282). (ORPHA:1272)
- Tapered finger (HP:0001182): The gradual reduction in girth of the finger from proximal to distal. Evidence: TAS. Frequency: Frequent (HP:0040282). (ORPHA:1272)
- Seizure (HP:0001250): A seizure is an intermittent abnormality of nervous system physiology characterized by a transient occurrence of signs and/or symptoms due to abnormal excessive or synchronous neuronal activity in the brain. Evidence: TAS. Frequency: Frequent (HP:0040282). (ORPHA:1272)
- Plagiocephaly (HP:0001357): Asymmetric head shape, which is usually a combination of unilateral occipital flattening with ipsilateral frontal prominence, leading to rhomboid cranial shape. Evidence: TAS. Frequency: Frequent (HP:0040282). (ORPHA:1272)
- Limitation of joint mobility (HP:0001376): A reduction in the freedom of movement of one or more joints. Evidence: TAS. Frequency: Frequent (HP:0040282). (ORPHA:1272)
- Bilateral ptosis (HP:0001488). Evidence: TAS. Frequency: Frequent (HP:0040282). (ORPHA:1272)
- Rocker bottom foot (HP:0001838): The presence of both a prominent heel and a convex contour of the sole. Evidence: TAS. Frequency: Frequent (HP:0040282). (ORPHA:1272)
- Ventriculomegaly (HP:0002119): An increase in size of the ventricular system of the brain. Evidence: TAS. Frequency: Frequent (HP:0040282). (ORPHA:1272)
- Cerebral cortical atrophy (HP:0002120): Atrophy of the cortex of the cerebrum. Evidence: TAS. Frequency: Frequent (HP:0040282). (ORPHA:1272)
- Sparse scalp hair (HP:0002209): Decreased number of hairs per unit area of skin of the scalp. Evidence: TAS. Frequency: Frequent (HP:0040282). (ORPHA:1272)
- EEG abnormality (HP:0002353): Abnormality observed by electroencephalogram (EEG), which is used to record of the brain's spontaneous electrical activity from multiple electrodes placed on the scalp. Evidence: TAS. Frequency: Frequent (HP:0040282). (ORPHA:1272)
- Short nose (HP:0003196): Distance from nasion to subnasale more than two standard deviations below the mean, or alternatively, an apparently decreased length from the nasal root to the nasal tip. Evidence: TAS. Frequency: Frequent (HP:0040282). (ORPHA:1272)
- Clinodactyly of the 5th finger (HP:0004209): Clinodactyly refers to a bending or curvature of the fifth finger in the radial direction (i.e., towards the 4th finger). Evidence: TAS. Frequency: Frequent (HP:0040282). (ORPHA:1272)
- Short stature (HP:0004322): A height below that which is expected according to age and gender norms. Although there is no universally accepted definition of short stature, many refer to "short stature" as height more than 2 standard deviations below the mean for age and gender (or below the 3rd percentile for age and gender dependent norms). Evidence: TAS. Frequency: Frequent (HP:0040282). (ORPHA:1272)
- Depressed nasal bridge (HP:0005280): Posterior positioning of the nasal root in relation to the overall facial profile for age. Evidence: TAS. Frequency: Frequent (HP:0040282). (ORPHA:1272)
- Prominent metopic ridge (HP:0005487): Vertical bony ridge positioned in the midline of the forehead. Evidence: TAS. Frequency: Frequent (HP:0040282). (ORPHA:1272)
- Chiari type I malformation (HP:0007099): Arnold-Chiari type I malformation refers to a relatively mild degree of herniation of the posteroinferior region of the cerebellum (the cerebellar tonsils) into the cervical canal with little or no displacement of the fourth ventricle. It is characterized by one or both pointed (not rounded) cerebellar tonsils that project 5 mm below the foramen magnum, measured by a line drawn from the basion to the opisthion (McRae Line). Evidence: TAS. Frequency: Frequent (HP:0040282). (ORPHA:1272)
- Microtia (HP:0008551): Underdevelopment of the external ear. Evidence: TAS. Frequency: Frequent (HP:0040282). (ORPHA:1272)
- Floppy infant (HP:0008947): Floppiness/hypotonia is defined as reduced resistance to passive movement of joints. Physical examination of floppy/hypotonic infants shows head lag, lack of shoulder and elbow muscle contraction on traction response, inability to tighten the shoulder girdle muscles (or slipping through) when held under the axillae, scarf sign (when the arm is pulled to the opposite side, the arm wraps around the neck with the elbow crossing midline), hyperdorsiflexion of the feet, easy apposition of the thumb against the forearm, feet touching the cheek with ease and without discomfort, frog leg position, and inverted U sign on ventral suspension (head, arms, and legs hanging down without elbow or knee flexion and the trunk rounded in a dome shape). Evidence: TAS. Frequency: Frequent (HP:0040282). (ORPHA:1272)
- Asymmetric crying face (HP:0011333): Asymmetry observed in the face of a neonate or infant whose face appears symmetric at rest and asymmetric during crying as the mouth is pulled downward on one side while not moving on the other side. Evidence: TAS. Frequency: Frequent (HP:0040282). (ORPHA:1272)
- Camptodactyly (HP:0012385): The distal interphalangeal joint and/or the proximal interphalangeal joint of the fingers or toes cannot be extended to 180 degrees by either active or passive extension. Evidence: TAS. Frequency: Frequent (HP:0040282). (ORPHA:1272)
- Inguinal hernia (HP:0000023): Protrusion of the contents of the abdominal cavity through the inguinal canal. Evidence: TAS. Frequency: Occasional (HP:0040283). (ORPHA:1272)
- Proteinuria (HP:0000093): Increased levels of protein in the urine. Evidence: TAS. Frequency: Occasional (HP:0040283). (ORPHA:1272)
- Delayed cranial suture closure (HP:0000270): Infants normally have two fontanels at birth, the diamond-shaped anterior fontanelle at the junction of the coronal and sagittal sutures, and the posterior fontanelle at the intersection of the occipital and parietal bones. The posterior fontanelle usually closes by the 8th week of life, and the anterior fontanel closes by the 18th month of life on average. This term applies if there is delay of closure of the fontanelles beyond the normal age. Evidence: TAS. Frequency: Occasional (HP:0040283). (ORPHA:1272)
- Stenosis of the external auditory canal (HP:0000402): An abnormal narrowing of the external auditory canal. Evidence: TAS. Frequency: Occasional (HP:0040283). (ORPHA:1272)
- Megalocornea (HP:0000485): An enlargement of the cornea with normal clarity and function. Megalocornea is diagnosed with a horizontal corneal diameter of 12 mm or more at birth or 13 mm or more after two years of age. Evidence: TAS. Frequency: Occasional (HP:0040283). (ORPHA:1272)
- Glaucoma (HP:0000501): Glaucoma refers loss of retinal ganglion cells in a characteristic pattern of optic neuropathy usually associated with increased intraocular pressure. Evidence: TAS. Frequency: Occasional (HP:0040283). (ORPHA:1272)
- Long eyelashes (HP:0000527): Mid upper eyelash length >10 mm or increased length of the eyelashes (subjective). Evidence: TAS. Frequency: Occasional (HP:0040283). (ORPHA:1272)
- Abnormal thorax morphology (HP:0000765): Any abnormality of the thorax (the region of the body formed by the sternum, the thoracic vertebrae and the ribs). Evidence: TAS. Frequency: Occasional (HP:0040283). (ORPHA:1272)
- Congenital diaphragmatic hernia (HP:0000776): The presence of a hernia of the diaphragm present at birth. Evidence: TAS. Frequency: Occasional (HP:0040283). (ORPHA:1272)
- Craniosynostosis (HP:0001363): Craniosynostosis refers to the premature closure of the cranial sutures. Primary craniosynostosis refers to the closure of one or more sutures due to abnormalities in skull development, and secondary craniosynostosis results from failure of brain growth. Evidence: TAS. Frequency: Occasional (HP:0040283). (ORPHA:1272)
- Patent ductus arteriosus (HP:0001643): In utero, the ductus arteriosus (DA) serves to divert ventricular output away from the lungs and toward the placenta by connecting the main pulmonary artery to the descending aorta. A patent ductus arteriosus (PDA) in the first 3 days of life is a physiologic shunt in healthy term and preterm newborn infants, and normally is substantially closed within about 24 hours after bith and completely closed after about three weeks. Failure of physiologcal closure is referred to a persistent or patent ductus arteriosus (PDA). Depending on the degree of left-to-right shunting, PDA can have clinical consequences. Evidence: TAS. Frequency: Occasional (HP:0040283). (ORPHA:1272)
- Pericardial effusion (HP:0001698): Accumulation of fluid within the pericardium. Evidence: TAS. Frequency: Occasional (HP:0040283). (ORPHA:1272)
- Pericarditis (HP:0001701): Inflammation of the sac-like covering around the heart (pericardium). Evidence: TAS. Frequency: Occasional (HP:0040283). (ORPHA:1272)
- Hypoplasia of the corpus callosum (HP:0002079): Underdevelopment of the corpus callosum. Evidence: TAS. Frequency: Occasional (HP:0040283). (ORPHA:1272)
- Febrile seizure (within the age range of 3 months to 6 years) (HP:0002373): A febrile seizure is any type of seizure (most often a generalized tonic-clonic seizure) occurring with fever (at least 38 degrees Celsius) but in the absence of central nervous system infection, severe metabolic disturbance or other alternative precipitant in children between the ages of 3 months and 6 years. Evidence: TAS. Frequency: Occasional (HP:0040283). (ORPHA:1272)
- Scoliosis (HP:0002650): The presence of an abnormal lateral curvature of the spine. Evidence: TAS. Frequency: Occasional (HP:0040283). (ORPHA:1272)
- J-shaped sella turcica (HP:0002680): A deformity of the sella turcica whereby the sella extends further anterior than normal such that the anterior clinoid process appears to overhang it, giving the appearance of the letter J on imaging of the skull. Evidence: TAS. Frequency: Occasional (HP:0040283). (ORPHA:1272)
- Radioulnar synostosis (HP:0002974): An abnormal osseous union (fusion) between the radius and the ulna. Evidence: TAS. Frequency: Occasional (HP:0040283). (ORPHA:1272)
- Breast hypoplasia (HP:0003187): Underdevelopment of the breast. Evidence: TAS. Frequency: Occasional (HP:0040283). (ORPHA:1272)
- Supernumerary ribs (HP:0005815): The presence of more than 12 rib pairs. Evidence: TAS. Frequency: Occasional (HP:0040283). (ORPHA:1272)
- Reduced arm span (HP:0012770): Decreased length of the arm span (length from one end of an individual's arms measured at the fingertips to the other when raised parallel to the ground at shoulder height at a one-hundred eighty degree angle). Evidence: TAS. Frequency: Occasional (HP:0040283). (ORPHA:1272)
- Abnormal cardiovascular system morphology (HP:0030680): Any structural anomaly of the heart and blood vessels. Evidence: TAS. Frequency: Occasional (HP:0040283). (ORPHA:1272)